Phenotypes associated with the disease muscular atrophy, malignant neurogenic (OMIM:158650):
- Skeletal muscle atrophy (HP:0003202): The presence of skeletal muscular atrophy (which is also known as amyotrophy). Evidence: TAS. (OMIM:158650)
- Adult onset (HP:0003581): Onset of disease manifestations in adulthood, defined here as at the age of 16 years or later. Evidence: TAS. (OMIM:158650)
- Respiratory paralysis (HP:0002203): Inability to move the muscles of respiration. Evidence: TAS. (OMIM:158650)
- Autosomal dominant inheritance (HP:0000006): A mode of inheritance that is observed for traits related to a gene encoded on one of the autosomes (i.e., the human chromosomes 1-22) in which a trait manifests in heterozygotes. In the context of medical genetics, an autosomal dominant disorder is caused when a single copy of the mutant allele is present. Males and females are affected equally, and can both transmit the disorder with a risk of 50% for each child of inheriting the mutant allele. Evidence: TAS. (OMIM:158650)